- Micromelia (HP:0002983): The presence of abnormally small extremities. Evidence: TAS. Frequency: Occasional (HP:0040283). (OMIM:259775)
- Brachyturricephaly (HP:0000244): Abnormal vertical height of the skull and a shortening of its anterior-posterior length, frequently combined with malformations of the occipital region. Evidence: TAS. (OMIM:259775)
- Short stature (HP:0004322): A height below that which is expected according to age and gender norms. Although there is no universally accepted definition of short stature, many refer to "short stature" as height more than 2 standard deviations below the mean for age and gender (or below the 3rd percentile for age and gender dependent norms). Evidence: TAS. (OMIM:259775)
- Thoracic hypoplasia (HP:0005257). Evidence: PCS. Frequency: 6/7. (PMID:17924334)
- Elevated circulating alkaline phosphatase concentration (HP:0003155): Abnormally increased serum levels of alkaline phosphatase activity. Evidence: TAS. (OMIM:259775)
- Narrow mouth (HP:0000160): Distance between the commissures of the mouth more than 2 SD below the mean. Alternatively, an apparently decreased width of the oral aperture (subjective). Evidence: TAS. (OMIM:259775)
- Protruding tongue (HP:0010808): Tongue extending beyond the alveolar ridges or teeth at rest. Evidence: TAS. (OMIM:259775)
- Short nose (HP:0003196): Distance from nasion to subnasale more than two standard deviations below the mean, or alternatively, an apparently decreased length from the nasal root to the nasal tip. Evidence: TAS. (OMIM:259775)
- Hypertelorism (HP:0000316): Interpupillary distance more than 2 SD above the mean (alternatively, the appearance of an increased interpupillary distance or widely spaced eyes). Evidence: TAS. (OMIM:259775)
- Large fontanelles (HP:0000239): In newborns, the two frontal bones, two parietal bones, and one occipital bone are joined by fibrous sutures, which form a small posterior fontanelle, and a larger, diamond-shaped anterior fontanelle. These regions allow for the skull to pass the birth canal and for later growth. The fontanelles gradually ossify, whereby the posterior fontanelle usually closes by eight weeks and the anterior fontanelle by the 9th to 16th month of age. Large fontanelles are diagnosed if the fontanelles are larger than age-dependent norms. Evidence: TAS. (OMIM:259775)
- Hydrocephalus (HP:0000238): Hydrocephalus is an active distension of the ventricular system of the brain resulting from inadequate passage of CSF from its point of production within the cerebral ventricles to its point of absorption into the systemic circulation. Evidence: TAS. Frequency: Occasional (HP:0040283). (OMIM:259775)
- Long hallux (HP:0001847): Increased length of the big toe. Evidence: TAS. Frequency: Occasional (HP:0040283). (OMIM:259775)
- Death in infancy (HP:0001522): Death within the first 24 months of life. Evidence: PCS. Frequency: 7/7. (PMID:17924334)
- Posteriorly rotated ears (HP:0000358): A type of abnormal location of the ears in which the position of the ears is characterized by posterior rotation (the superior part of the ears is rotated towards the back of the head, and the inferior part of the ears towards the front). Evidence: TAS. Frequency: Occasional (HP:0040283). (OMIM:259775)
- Highly arched eyebrow (HP:0002553): Increased height of the central portion of the eyebrow, forming a crescent, semicircular, or inverted U shape. Evidence: TAS. Frequency: Occasional (HP:0040283). (OMIM:259775)
- Cleft palate (HP:0000175): Cleft palate is a developmental defect of the palate resulting from a failure of fusion of the palatine processes and manifesting as a separation of the roof of the mouth (soft and hard palate). Evidence: TAS. (OMIM:259775)
- Downslanted palpebral fissures (HP:0000494): The palpebral fissure inclination is more than two standard deviations below the mean. Evidence: TAS. (OMIM:259775)
- Microcephaly (HP:0000252): Head circumference below 2 standard deviations below the mean for age and gender. Evidence: TAS. (OMIM:259775)
- Choanal atresia (HP:0000453): Absence or abnormal closure of the choana (the posterior nasal aperture). Most embryologists believe that posterior choanal atresia results from a failure of rupture between the 35th and 38th day of fetal life of the partition which separates the bucconasal or buccopharyngeal membranes. The resultant choanal atresia may be unilateral or bilateral, bony or membranous, complete or incomplete. In over 90 per cent of cases the obstruction is bony, while in the remainder it is membranous. The bony type of atresia is commonly located 1-2 mm. anterior to the posterior edge of the hard palate, and the osseous septum varies in thickness from 1 to 10 mm. In the membranous form of choanal atresia the obstruction usually occurs further posteriorly. In approximately one third of cases the atresia is bilateral. Evidence: TAS. (OMIM:259775)
- Natal tooth (HP:0000695): A tooth present at birth or erupting within the first month of life. Evidence: TAS. Frequency: Occasional (HP:0040283). (OMIM:259775)
- Choanal stenosis (HP:0000452): Abnormal narrowing of the choana (the posterior nasal aperture). Evidence: TAS. (OMIM:259775)
- Global developmental delay (HP:0001263): A delay in the achievement of motor or mental milestones in the domains of development of a child, including motor skills, speech and language, cognitive skills, and social and emotional skills. This term should only be used to describe children younger than five years of age. Evidence: TAS. (OMIM:259775)
- Microdontia (HP:0000691): Decreased size of the teeth, which can be defined as a mesiodistal tooth diameter (width) more than 2 SD below mean. Alternatively, an apparently decreased maximum width of tooth. Evidence: TAS. Frequency: Occasional (HP:0040283). (OMIM:259775)
- Midface retrusion (HP:0011800): Posterior positions and/or vertical shortening of the infraorbital and perialar regions, or increased concavity of the face and/or reduced nasolabial angle. Evidence: TAS. (OMIM:259775)
- Pectus excavatum (HP:0000767): A defect of the chest wall characterized by a depression of the sternum, giving the chest ("pectus") a caved-in ("excavatum") appearance. Evidence: TAS. Frequency: Occasional (HP:0040283). (OMIM:259775)
- Autosomal recessive inheritance (HP:0000007): A mode of inheritance that is observed for traits related to a gene encoded on one of the autosomes (i.e., the human chromosomes 1-22) in which a trait manifests in individuals with two pathogenic alleles, either homozygotes (two copies of the same mutant allele) or compound heterozygotes (whereby each copy of a gene has a distinct mutant allele). Evidence: PCS. (PMID:17924334)
- Proptosis (HP:0000520): An eye that is protruding anterior to the plane of the face to a greater extent than is typical. Evidence: TAS. (OMIM:259775)
- Brachycephaly (HP:0000248): An abnormality of skull shape characterized by a decreased anterior-posterior diameter. That is, a cephalic index greater than 81%. Alternatively, an apparently shortened anteroposterior dimension (length) of the head compared to width. Evidence: TAS. (OMIM:259775)
- Hypophosphatemia (HP:0002148): The concentration of phosphate ion in the blood circulation is below the lower limit of normal. Evidence: TAS. (OMIM:259775)
- Low-set ears (HP:0000369): Upper insertion of the ear to the scalp below an imaginary horizontal line drawn between the inner canthi of the eye and extending posteriorly to the ear. Evidence: TAS. (OMIM:259775)
- Hydronephrosis (HP:0000126): Severe distention of the kidney with dilation of the renal pelvis and calices. Evidence: TAS. Frequency: Occasional (HP:0040283). (OMIM:259775)
- Congenital onset (HP:0003577): A phenotypic abnormality that is present at birth. Evidence: PCS. Frequency: 7/7. (PMID:17924334)
- Pulmonary hypoplasia (HP:0002089). Evidence: PCS. Frequency: 4/7. (PMID:17924334)
- Brachydactyly (HP:0001156): Digits that appear disproportionately short compared to the hand/foot. The word brachydactyly is used here to describe a series distinct patterns of shortened digits (brachydactyly types A-E). This is the sense used here. Evidence: TAS. Frequency: Occasional (HP:0040283). (OMIM:259775)
- Subperiosteal bone formation (HP:0031485): The formation of new bone along the cortex and underneath the periosteum of a bone. Evidence: PCS. Frequency: 7/7. (PMID:17924334)
- Increased bone mineral density (HP:0011001): An abnormal increase of bone mineral density, that is, of the amount of matter per cubic centimeter of bones which is often referred to as osteosclerosis. Osteosclerosis can be detected on radiological examination as an increased whiteness (density) of affected bones. Evidence: TAS. Onset: Neonatal onset (HP:0003623). (OMIM:259775)
- Increased bone mineral density (HP:0011001): An abnormal increase of bone mineral density, that is, of the amount of matter per cubic centimeter of bones which is often referred to as osteosclerosis. Osteosclerosis can be detected on radiological examination as an increased whiteness (density) of affected bones. Evidence: PCS. Frequency: 7/7. (PMID:17924334)
- Enamel hypoplasia (HP:0006297): Developmental hypoplasia of the dental enamel. Evidence: TAS. Frequency: Occasional (HP:0040283). (OMIM:259775)
- High palate (HP:0000218): Height of the palate more than 2 SD above the mean (objective) or palatal height at the level of the first permanent molar more than twice the height of the teeth (subjective). Evidence: TAS. (OMIM:259775)
- Protruding ear (HP:0000411): Angle formed by the plane of the ear and the mastoid bone greater than the 97th centile for age (objective); or, outer edge of the helix more than 2 cm from the mastoid at the point of maximum distance (objective). Evidence: TAS. Frequency: Occasional (HP:0040283). (OMIM:259775)
- Abnormal pinna morphology (HP:0000377): An abnormality of the pinna, which is also referred to as the auricle or external ear. Evidence: TAS. Frequency: Occasional (HP:0040283). (OMIM:259775)
- Cerebral calcification (HP:0002514): The presence of calcium deposition within the cerebrum. Evidence: PCS. Frequency: 3/4. (PMID:17924334)
- Gingival overgrowth (HP:0000212): Hyperplasia of the gingiva (that is, a thickening of the soft tissue overlying the alveolar ridge. The degree of thickening ranges from involvement of the interdental papillae alone to gingival overgrowth covering the entire tooth crown. Evidence: TAS. (OMIM:259775)
- Mixed hearing impairment (HP:0000410): A type of hearing loss resulting from a combination of conductive hearing impairment and sensorineural hearing impairment. Evidence: TAS. Frequency: Occasional (HP:0040283). (OMIM:259775)
- Wide mouth (HP:0000154): Distance between the oral commissures more than 2 SD above the mean. Alternatively, an apparently increased width of the oral aperture (subjective). Evidence: TAS. Frequency: Occasional (HP:0040283). (OMIM:259775)
- Hydroureter (HP:0000072): The distention of the ureter with urine. Evidence: TAS. Frequency: Occasional (HP:0040283). (OMIM:259775)
- Malar flattening (HP:0000272): Underdevelopment of the malar prominence of the jugal bone (zygomatic bone in mammals), appreciated in profile, frontal view, and/or by palpation. Evidence: TAS. (OMIM:259775)
- Short neck (HP:0000470): Diminished length of the neck. Evidence: TAS. (OMIM:259775)
- Depressed nasal bridge (HP:0005280): Posterior positioning of the nasal root in relation to the overall facial profile for age. Evidence: TAS. (OMIM:259775)
- Arthrogryposis multiplex congenita (HP:0002804): Multiple congenital contractures in different body areas. Evidence: TAS. Frequency: Occasional (HP:0040283). (OMIM:259775)
- Bowing of the long bones (HP:0006487): A bending or abnormal curvature of a long bone. Evidence: TAS. Frequency: Occasional (HP:0040283). (OMIM:259775)
- Neonatal death (HP:0003811): Death within the first 28 days of life. Evidence: IEA. (OMIM:259775)
- Plagiocephaly (HP:0001357): Asymmetric head shape, which is usually a combination of unilateral occipital flattening with ipsilateral frontal prominence, leading to rhomboid cranial shape. Evidence: TAS. Frequency: Occasional (HP:0040283). (OMIM:259775)
- Mandibular prognathia (HP:0000303): Abnormal prominence of the chin related to increased length of the mandible. Evidence: TAS. Frequency: Occasional (HP:0040283). (OMIM:259775)
- Micrognathia (HP:0000347): Developmental hypoplasia of the mandible. Evidence: TAS. (OMIM:259775)
These phenotypes are associated with the disease lethal osteosclerotic bone dysplasia (OMIM:259775).